Phenotypes associated with the disease Rotor syndrome (OMIM:237450):
- Abnormal skin pigmentation (HP:0001000): An abnormality of the pigmentation of the skin. Evidence: IEA. (OMIM:237450)
- Conjugated hyperbilirubinemia (HP:0002908). Evidence: IEA. (OMIM:237450)
- Abnormality of the skeletal system (HP:0000924): An abnormality of the skeletal system. Evidence: IEA. (OMIM:237450)
- Digenic inheritance (HP:0010984): A type of multifactorial inheritance governed by the simultaneous action of two gene loci. Evidence: PCS. (PMID:22232210)
- Jaundice (HP:0000952): Yellow pigmentation of the skin due to bilirubin, which in turn is the result of increased bilirubin concentration in the bloodstream. Evidence: IEA. (OMIM:237450)